Phenotypes associated with the disease clonic hemifacial spasm (OMIM:141405):
- Abnormality of the nervous system (HP:0000707): An abnormality of the nervous system. Evidence: IEA. (OMIM:141405)
- Hemifacial spasm (HP:0010828): Intermittent clonic or tonic contraction of muscles supplied by facial nerve. Muscles are relaxed in between contractions. Evidence: TAS. (OMIM:141405)
- Autosomal dominant inheritance (HP:0000006): A mode of inheritance that is observed for traits related to a gene encoded on one of the autosomes (i.e., the human chromosomes 1-22) in which a trait manifests in heterozygotes. In the context of medical genetics, an autosomal dominant disorder is caused when a single copy of the mutant allele is present. Males and females are affected equally, and can both transmit the disorder with a risk of 50% for each child of inheriting the mutant allele. Evidence: IEA. (OMIM:141405)